Phenotypes associated with the disease Drug-induced lupus erythematosus (ORPHA:231111):
- Hematuria (HP:0000790): The presence of blood in the urine. Hematuria may be gross hematuria (visible to the naked eye) or microscopic hematuria (detected by dipstick or microscopic examination of the urine). Evidence: TAS. Frequency: Very frequent (HP:0040281). (ORPHA:231111)
- Petechiae (HP:0000967): Petechiae are pinpoint-sized reddish/purple spots, resembling a rash, that appear just under the skin or a mucous membrane when capillaries have ruptured and some superficial bleeding into the skin has happened. This term refers to an abnormally increased susceptibility to developing petechiae. Evidence: TAS. Frequency: Very frequent (HP:0040281). (ORPHA:231111)
- Pericardial effusion (HP:0001698): Accumulation of fluid within the pericardium. Evidence: TAS. Frequency: Very frequent (HP:0040281). (ORPHA:231111)
- Pericarditis (HP:0001701): Inflammation of the sac-like covering around the heart (pericardium). Evidence: TAS. Frequency: Very frequent (HP:0040281). (ORPHA:231111)
- Thrombocytopenia (HP:0001873): A reduction in the number of circulating thrombocytes. Evidence: TAS. Frequency: Very frequent (HP:0040281). (ORPHA:231111)
- Anemia (HP:0001903): A reduction in erythrocytes volume or hemoglobin concentration. Evidence: TAS. Frequency: Very frequent (HP:0040281). (ORPHA:231111)
- Dyspnea (HP:0002094): Difficult or labored breathing. Dyspnea is a subjective feeling only the patient can rate, e.g., on a Borg scale. Evidence: TAS. Frequency: Very frequent (HP:0040281). (ORPHA:231111)
- Arthralgia (HP:0002829): Joint pain. Evidence: TAS. Frequency: Very frequent (HP:0040281). (ORPHA:231111)
- Increased blood urea nitrogen (HP:0003138): An increased amount of nitrogen in the form of urea in the blood. Evidence: TAS. Frequency: Very frequent (HP:0040281). (ORPHA:231111)
- Elevated circulating creatine kinase activity (HP:0003236): The activity of creatine kinase in the blood circulation is above the upper limit of normal. Evidence: TAS. Frequency: Very frequent (HP:0040281). (ORPHA:231111)
- Myalgia (HP:0003326): Pain in muscle. Evidence: TAS. Frequency: Very frequent (HP:0040281). (ORPHA:231111)
- Antinuclear antibody positivity (HP:0003493): The presence of autoantibodies in the serum that react against nuclei or nuclear components. Evidence: TAS. Frequency: Very frequent (HP:0040281). (ORPHA:231111)
- Elevated erythrocyte sedimentation rate (HP:0003565): An increased erythrocyte sedimentation rate (ESR). The ESR is a test that measures the distance that erythrocytes have fallen after one hour in a vertical column of anticoagulated blood under the influence of gravity. The ESR is a nonspecific finding. An elevation may indicate inflammation or may be caused by any condition that elevates fibrinogen. Evidence: TAS. Frequency: Very frequent (HP:0040281). (ORPHA:231111)
- Prolonged QTc interval (HP:0005184): A longer than normal interval (corrected for heart rate) between the Q and T waves in the heart's cycle. Prolonged QTc can cause premature action potentials during late phase depolarizations thereby leading to ventricular arrhythmias and ventricular fibrillations. Evidence: TAS. Frequency: Very frequent (HP:0040281). (ORPHA:231111)
- Decreased circulating complement C3 concentration (HP:0005421): Concentration of the complement component C3 in the blood circulation below the lower limit of normal. Evidence: TAS. Frequency: Very frequent (HP:0040281). (ORPHA:231111)
- Elevated circulating C-reactive protein concentration (HP:0011227): The concentration of C-reactive protein in the blood circulation is above the upper limit of normal. Evidence: TAS. Frequency: Very frequent (HP:0040281). (ORPHA:231111)
- Malar rash (HP:0025300): An erythematous (red), flat facial rash that affects the skin in the malar area (over the cheekbones) and extends over the bridge of the nose. Evidence: TAS. Frequency: Very frequent (HP:0040281). (ORPHA:231111)
- Lupus anticoagulant (HP:0025343): Presence of lupus anticoagulant (LA) autoantibodies. LA represent a heterogeneous group of autoantibodies, IgG, IgM, or a mixture of both classes, that interfere with standard phospholipid-based coagulant tests (this is only an in vitro phenomenon, LA do not cause reduction of coagulation in vivo). The antibodies are directed against plasma proteins which also bind to phospholipid surfaces. Evidence: TAS. Frequency: Very frequent (HP:0040281). (ORPHA:231111)
- Autoimmune antibody positivity (HP:0030057): The presence of an antibody in the blood circulation that is directed against the organism's own cells or tissues. Evidence: TAS. Frequency: Very frequent (HP:0040281). (ORPHA:231111)
- Decreased circulating complement C4 concentration (HP:0045042): Concentration of the complement component C4 in the blood circulation below the lower limit of normal. Evidence: TAS. Frequency: Very frequent (HP:0040281). (ORPHA:231111)
- Fever (HP:0001945): Body temperature elevated above the normal range. Evidence: TAS. Frequency: Frequent (HP:0040282). (ORPHA:231111)
- Serositis (HP:0045073): Inflammation in any serous cavity. Evidence: TAS. Frequency: Frequent (HP:0040282). (ORPHA:231111)
- Constitutional symptom (HP:0025142): A symptom or manifestation indicating a systemic or general effect of a disease and that may affect the general well-being or status of an individual. Evidence: TAS. Frequency: Occasional (HP:0040283). (ORPHA:231111)